- Paroxysmal dystonia (HP:0002268): A form of dystonia characterized by episodes of dystonia (often hemidystonia or generalized) lasting from minutes to hours. There are no dystonic symptoms between episodes. Evidence: TAS. (OMIM:611147)
- Seizure (HP:0001250): A seizure is an intermittent abnormality of nervous system physiology characterized by a transient occurrence of signs and/or symptoms due to abnormal excessive or synchronous neuronal activity in the brain. Evidence: IEA. (OMIM:611147)
- Migraine (HP:0002076): Migraine is a chronic neurological disorder characterized by episodic attacks of headache and associated symptoms. Evidence: TAS. Frequency: Occasional (HP:0040283). (OMIM:611147)
- Typified by incomplete penetrance (HP:0003829): Description of conditions in which not all individuals with a given genotype exhibit the disease. Penetrance is the proportion that develop disease given a lifespan of 80 years. Evidence: IEA. (OMIM:611147)
- Autosomal dominant inheritance (HP:0000006): A mode of inheritance that is observed for traits related to a gene encoded on one of the autosomes (i.e., the human chromosomes 1-22) in which a trait manifests in heterozygotes. In the context of medical genetics, an autosomal dominant disorder is caused when a single copy of the mutant allele is present. Males and females are affected equally, and can both transmit the disorder with a risk of 50% for each child of inheriting the mutant allele. Evidence: IEA. (OMIM:611147)
These phenotypes are associated with the disease paroxysmal nonkinesigenic dyskinesia 2 (OMIM:611147).